- Hypsarrhythmia (HP:0002521): Hypsarrhythmia is abnormal interictal high amplitude waves and a background of irregular spikes. There is continuous (during wakefulness), high-amplitude (>200 Hz), generalized polymorphic slowing with no organized background and multifocal spikes demonstrated by electroencephalography (EEG). Evidence: PCS. Frequency: 1/1. (PMID:25102098)
- Thick eyebrow (HP:0000574): Increased density/number and/or increased diameter of eyebrow hairs. Evidence: PCS. Frequency: 1/1. (PMID:25102098)
- Seizure (HP:0001250): A seizure is an intermittent abnormality of nervous system physiology characterized by a transient occurrence of signs and/or symptoms due to abnormal excessive or synchronous neuronal activity in the brain. Evidence: TAS. Frequency: Occasional (HP:0040283). (OMIM:616944)
- Hypotonia (HP:0001252): Hypotonia is an abnormally low muscle tone (the amount of tension or resistance to movement in a muscle). Even when relaxed, muscles have a continuous and passive partial contraction which provides some resistance to passive stretching. Hypotonia thus manifests as diminished resistance to passive stretching. Hypotonia is not the same as muscle weakness, although the two conditions can co-exist. Evidence: PCS. Frequency: 1/1. (PMID:25102098)
- Global developmental delay (HP:0001263): A delay in the achievement of motor or mental milestones in the domains of development of a child, including motor skills, speech and language, cognitive skills, and social and emotional skills. This term should only be used to describe children younger than five years of age. Evidence: PCS. Frequency: 1/1. (PMID:25102098)
- Infantile onset (HP:0003593): Onset of signs or symptoms of disease between 28 days to one year of life. Evidence: PCS. Frequency: 1/1. (PMID:25102098)
- Epileptic spasm (HP:0011097): A sudden flexion, extension, or mixed extension-flexion of predominantly proximal and truncal muscles that is usually more sustained than a myoclonic movement but not as sustained as a tonic seizure. Limited forms may occur: Grimacing, head nodding, or subtle eye movements. Epileptic spasms frequently occur in clusters. Infantile spasms are the best known form, but spasms can occur at all ages. Evidence: PCS. Frequency: 1/1. (PMID:25102098)
- Tonic seizure (HP:0032792): A tonic seizure is a type of motor seizure characterized by unilateral or bilateral limb stiffening or elevation, often with neck stiffening. Evidence: PCS. Frequency: 1/1. (PMID:25102098)
- Autistic behavior (HP:0000729): Persistent deficits in social interaction and communication and interaction as well as a markedly restricted repertoire of activity and interest as well as repetitive patterns of behavior. Evidence: PCS. Frequency: 1/1. (PMID:25102098)
- Long palpebral fissure (HP:0000637): Distance between medial and lateral canthi is more than two standard deviations above the mean for age (objective); or, apparently increased length of the palpebral fissures. Evidence: PCS. Frequency: 1/1. (PMID:25102098)
- Downturned corners of mouth (HP:0002714): A morphological abnormality of the mouth in which the angle of the mouth is downturned. The oral commissures are positioned inferior to the midline labial fissure. Evidence: PCS. Frequency: 1/1. (PMID:25102098)
- Intellectual disability (HP:0001249): The term intellectual disability or intellectual developmental disorder is used to describe significantly sub-average intellectual and adaptive functioning based on clinical assessment and as measured by individually administered, appropriately normed, standardized and validated tests of intellectual functioning and adaptive behavior, with onset during the developmental period from infancy through adolescence. Evidence: PCS. Frequency: 1/1. (PMID:25102098)
- Autosomal dominant inheritance (HP:0000006): A mode of inheritance that is observed for traits related to a gene encoded on one of the autosomes (i.e., the human chromosomes 1-22) in which a trait manifests in heterozygotes. In the context of medical genetics, an autosomal dominant disorder is caused when a single copy of the mutant allele is present. Males and females are affected equally, and can both transmit the disorder with a risk of 50% for each child of inheriting the mutant allele. Evidence: PCS. (PMID:25102098)
These phenotypes are associated with the disease intellectual disability, autosomal dominant 41 (OMIM:616944).